- Dolichocephaly (HP:0000268): An abnormality of skull shape characterized by a increased anterior-posterior diameter, i.e., an increased antero-posterior dimension of the skull. Cephalic index less than 76%. Alternatively, an apparently increased antero-posterior length of the head compared to width. Often due to premature closure of the sagittal suture. Evidence: TAS. Frequency: Frequent (HP:0040282). (ORPHA:2793)
- Macrotia (HP:0000400): Median longitudinal ear length greater than two standard deviations above the mean and median ear width greater than two standard deviations above the mean (objective); or, apparent increase in length and width of the pinna (subjective). Evidence: TAS. Frequency: Very frequent (HP:0040281). (ORPHA:2793)
- Upslanted palpebral fissure (HP:0000582): The palpebral fissure inclination is more than two standard deviations above the mean for age (objective); or, the inclination of the palpebral fissure is greater than typical for age. Evidence: TAS. Frequency: Frequent (HP:0040282). (ORPHA:2793)
- Abnormal diaphysis morphology (HP:0000940): An abnormality of the structure or form of the diaphysis, i.e., of the main or mid-section (shaft) of a long bone. Evidence: TAS. Frequency: Very frequent (HP:0040281). (ORPHA:2793)
- Mild intellectual disability (HP:0001256): Mild intellectual disability (ID) is defined as a type of ID characterized by mildly sub-average adaptive functioning and intellectual functioning, with an intelligence quotient (IQ) the range of 50-69. Evidence: TAS. Frequency: Very frequent (HP:0040281). (ORPHA:2793)
- Flexion contracture (HP:0001371): A flexion contracture is a bent (flexed) joint that cannot be straightened actively or passively. It is thus a chronic loss of joint motion due to structural changes in muscle, tendons, ligaments, or skin that prevents normal movement of joints. Evidence: TAS. Frequency: Very frequent (HP:0040281). (ORPHA:2793)
- Abnormal nail morphology (HP:0001597): Abnormal structure or appearance of the nail. Evidence: TAS. Frequency: Very frequent (HP:0040281). (ORPHA:2793)
- Knee flexion contracture (HP:0006380): A type of knee joint contracture in which the knee is in a fixed bent (flexed) configuration such that it cannot be straightened actively or passively. Evidence: TAS. Frequency: Very frequent (HP:0040281). (ORPHA:2793)
- Underfolded helix (HP:0008577): Underdevelopment of the helix that either affects the entire helix, or is localized. Evidence: TAS. Frequency: Very frequent (HP:0040281). (ORPHA:2793)
- Abnormal antihelix morphology (HP:0009738): An abnormality of the antihelix. Evidence: TAS. Frequency: Very frequent (HP:0040281). (ORPHA:2793)
- Popliteal pterygium (HP:0009756): A pterygium (or pterygia) occurring in the popliteal region (the back of the knee). Evidence: TAS. Frequency: Very frequent (HP:0040281). (ORPHA:2793)
- Aplasia/Hypoplasia of the earlobes (HP:0009906): Absence or underdevelopment of the ear lobes. Evidence: TAS. Frequency: Very frequent (HP:0040281). (ORPHA:2793)
- Abnormal helix morphology (HP:0011039): An abnormality of the helix. The helix is the outer rim of the ear that extends from the insertion of the ear on the scalp (root) to the termination of the cartilage at the earlobe. Evidence: TAS. Frequency: Very frequent (HP:0040281). (ORPHA:2793)
These phenotypes are associated with the disease Otoonychoperoneal syndrome (ORPHA:2793).